Phenotypes associated with the disease deafness, neural, congenital moderate (OMIM:221500):
- Sensorineural hearing impairment (HP:0000407): A type of hearing impairment in one or both ears related to an abnormal functionality of the cochlear nerve. Evidence: TAS. Onset: Congenital onset (HP:0003577). (OMIM:221500)
- Autosomal recessive inheritance (HP:0000007): A mode of inheritance that is observed for traits related to a gene encoded on one of the autosomes (i.e., the human chromosomes 1-22) in which a trait manifests in individuals with two pathogenic alleles, either homozygotes (two copies of the same mutant allele) or compound heterozygotes (whereby each copy of a gene has a distinct mutant allele). Evidence: TAS. (OMIM:221500)